Phenotypes associated with the disease urticaria, aquagenic (OMIM:191850):
- Urticaria (HP:0001025): Raised, well-circumscribed areas of erythema and edema involving the dermis and epidermis. Urticaria is intensely pruritic, and blanches completely with pressure. Evidence: TAS. (OMIM:191850)
- Autosomal dominant inheritance (HP:0000006): A mode of inheritance that is observed for traits related to a gene encoded on one of the autosomes (i.e., the human chromosomes 1-22) in which a trait manifests in heterozygotes. In the context of medical genetics, an autosomal dominant disorder is caused when a single copy of the mutant allele is present. Males and females are affected equally, and can both transmit the disorder with a risk of 50% for each child of inheriting the mutant allele. Evidence: IEA. (OMIM:191850)